Phenotypes associated with the disease developmental and epileptic encephalopathy, 72 (OMIM:618374):
- Axial hypotonia (HP:0008936): Muscular hypotonia (abnormally low muscle tone) affecting the musculature of the trunk. Evidence: PCS. Frequency: 1/2. (PMID:30323019)
- Hyperkinetic movements (HP:0002487): Motor hyperactivity with excessive movement of muscles of the body as a whole. Evidence: PCS. Frequency: 1/2. (PMID:30323019)
- Astigmatism (HP:0000483): A type of refraction error associated with abnormal curvatures on the anterior and/or posterior surface of the cornea. Evidence: PCS. Frequency: 1/2. (PMID:30323019)
- Cerebral atrophy (HP:0002059): Atrophy (wasting, decrease in size of cells or tissue) affecting the cerebrum. Evidence: PCS. Frequency: 2/2. (PMID:30323019)
- Dysphagia (HP:0002015): Difficulty in swallowing. Evidence: PCS. Frequency: 1/2. (PMID:30323019)
- Hypsarrhythmia (HP:0002521): Hypsarrhythmia is abnormal interictal high amplitude waves and a background of irregular spikes. There is continuous (during wakefulness), high-amplitude (>200 Hz), generalized polymorphic slowing with no organized background and multifocal spikes demonstrated by electroencephalography (EEG). Evidence: PCS. Frequency: 2/2. (PMID:30323019)
- Inability to walk (HP:0002540): Incapability to ambulate. Evidence: PCS. Frequency: 1/2. (PMID:30323019)
- Delayed CNS myelination (HP:0002188): Delayed myelination in the central nervous system. Evidence: PCS. Frequency: 1/2. (PMID:30323019)
- Delayed ability to walk (HP:0031936): A failure to achieve the ability to walk at an appropriate developmental stage. Most children learn to walk in a series of stages, and learn to walk short distances independently between 12 and 15 months. Evidence: PCS. Frequency: 2/2. (PMID:30323019)
- Hypoplasia of the corpus callosum (HP:0002079): Underdevelopment of the corpus callosum. Evidence: PCS. Frequency: 1/2. (PMID:30323019)
- Global developmental delay (HP:0001263): A delay in the achievement of motor or mental milestones in the domains of development of a child, including motor skills, speech and language, cognitive skills, and social and emotional skills. This term should only be used to describe children younger than five years of age. Evidence: PCS. Frequency: 2/2. (PMID:30323019)
- Infantile onset (HP:0003593): Onset of signs or symptoms of disease between 28 days to one year of life. Evidence: PCS. Frequency: 2/2. (PMID:30323019)
- Periventricular white matter hyperintensities (HP:0030891): Areas of brighter than expected signal on magnetic resonance imaging emanating from the cerebral white matter that surrounds the cerebral ventricles. Evidence: PCS. Frequency: 1/2. (PMID:30323019)
- Infantile spasms (HP:0012469): Infantile spasms represent a subset of "epileptic spasms". Infantile Spasms are epileptic spasms starting in the first year of life (infancy). Evidence: PCS. Frequency: 2/2. (PMID:30323019)
- Cerebral visual impairment (HP:0100704): A form of loss of vision caused by damage to the visual cortex rather than a defect in the eye. Evidence: PCS. Frequency: 1/2. (PMID:30323019)
- Reduced eye contact (HP:0000817): A reduced frequency or duration of eye contact. Evidence: PCS. Frequency: 1/2. (PMID:30323019)
- Epileptic encephalopathy (HP:0200134): A condition in which epileptiform abnormalities are believed to contribute to the progressive disturbance in cerebral function. Epileptic encephalaopathy is characterized by (1) electrographic EEG paroxysmal activity that is often aggressive, (2) seizures that are usually multiform and intractable, (3) cognitive, behavioral and neurological deficits that may be relentless, and (4) sometimes early death. Evidence: PCS. (PMID:30323019)
- Delayed ability to sit (HP:0025336): A failure to achieve the ability to sit at an appropriate developmental stage. Most children sit with support at 6 months of age and sit steadily without support at 9 months of age. Evidence: PCS. Frequency: 2/2. (PMID:30323019)
- Esotropia (HP:0000565): A form of strabismus with one or both eyes turned inward ('crossed') to a relatively severe degree, usually defined as 10 diopters or more. Evidence: PCS. Frequency: 1/2. (PMID:30323019)
- Autosomal dominant inheritance (HP:0000006): A mode of inheritance that is observed for traits related to a gene encoded on one of the autosomes (i.e., the human chromosomes 1-22) in which a trait manifests in heterozygotes. In the context of medical genetics, an autosomal dominant disorder is caused when a single copy of the mutant allele is present. Males and females are affected equally, and can both transmit the disorder with a risk of 50% for each child of inheriting the mutant allele. Evidence: PCS. (PMID:30323019)